- Abnormality of the dentition (HP:0000164): Any abnormality of the teeth. Evidence: TAS. Frequency: Very frequent (HP:0040281). (ORPHA:3268)
- Microcephaly (HP:0000252): Head circumference below 2 standard deviations below the mean for age and gender. Evidence: TAS. Frequency: Very frequent (HP:0040281). (ORPHA:3268)
- Epicanthus (HP:0000286): A fold of skin starting above the medial aspect of the upper eyelid and arching downward to cover, pass in front of and lateral to the medial canthus. Evidence: TAS. Frequency: Very frequent (HP:0040281). (ORPHA:3268)
- Abnormality of the philtrum (HP:0000288): An abnormality of the philtrum. Evidence: TAS. Frequency: Very frequent (HP:0040281). (ORPHA:3268)
- Thick eyebrow (HP:0000574): Increased density/number and/or increased diameter of eyebrow hairs. Evidence: TAS. Frequency: Very frequent (HP:0040281). (ORPHA:3268)
- Synophrys (HP:0000664): Meeting of the medial eyebrows in the midline. Evidence: TAS. Frequency: Very frequent (HP:0040281). (ORPHA:3268)
- Pectus carinatum (HP:0000768): A deformity of the chest caused by overgrowth of the ribs and characterized by protrusion of the sternum. Evidence: TAS. Frequency: Very frequent (HP:0040281). (ORPHA:3268)
- Abnormal rib morphology (HP:0000772): An anomaly of the rib. Evidence: TAS. Frequency: Very frequent (HP:0040281). (ORPHA:3268)
- Intellectual disability (HP:0001249): The term intellectual disability or intellectual developmental disorder is used to describe significantly sub-average intellectual and adaptive functioning based on clinical assessment and as measured by individually administered, appropriately normed, standardized and validated tests of intellectual functioning and adaptive behavior, with onset during the developmental period from infancy through adolescence. Evidence: TAS. Frequency: Very frequent (HP:0040281). (ORPHA:3268)
- Global developmental delay (HP:0001263): A delay in the achievement of motor or mental milestones in the domains of development of a child, including motor skills, speech and language, cognitive skills, and social and emotional skills. This term should only be used to describe children younger than five years of age. Evidence: TAS. Frequency: Very frequent (HP:0040281). (ORPHA:3268)
- Premature birth (HP:0001622): The birth of a baby of less than 37 weeks of gestational age. Evidence: TAS. Frequency: Very frequent (HP:0040281). (ORPHA:3268)
- Scoliosis (HP:0002650): The presence of an abnormal lateral curvature of the spine. Evidence: TAS. Frequency: Very frequent (HP:0040281). (ORPHA:3268)
- Delayed skeletal maturation (HP:0002750): A decreased rate of skeletal maturation. Delayed skeletal maturation can be diagnosed on the basis of an estimation of the bone age from radiographs of specific bones in the human body. Evidence: TAS. Frequency: Very frequent (HP:0040281). (ORPHA:3268)
- Radioulnar synostosis (HP:0002974): An abnormal osseous union (fusion) between the radius and the ulna. Evidence: TAS. Frequency: Very frequent (HP:0040281). (ORPHA:3268)
- Clinodactyly of the 5th finger (HP:0004209): Clinodactyly refers to a bending or curvature of the fifth finger in the radial direction (i.e., towards the 4th finger). Evidence: TAS. Frequency: Very frequent (HP:0040281). (ORPHA:3268)
- Short stature (HP:0004322): A height below that which is expected according to age and gender norms. Although there is no universally accepted definition of short stature, many refer to "short stature" as height more than 2 standard deviations below the mean for age and gender (or below the 3rd percentile for age and gender dependent norms). Evidence: TAS. Frequency: Very frequent (HP:0040281). (ORPHA:3268)
- Finger syndactyly (HP:0006101): Webbing or fusion of the fingers, involving soft parts only or including bone structure. Bony fusions are referred to as "bony" Syndactyly if the fusion occurs in a radio-ulnar axis. Fusions of bones of the fingers in a proximo-distal axis are referred to as "Symphalangism". Evidence: TAS. Frequency: Very frequent (HP:0040281). (ORPHA:3268)
- Abnormal dermatoglyphics (HP:0007477): An abnormality of dermatoglyphs (fingerprints), which are present on fingers, palms, toes, and soles. Evidence: TAS. Frequency: Very frequent (HP:0040281). (ORPHA:3268)
- Abnormality of the elbow (HP:0009811): An anomaly of the joint that connects the upper and the lower arm. Evidence: TAS. Frequency: Very frequent (HP:0040281). (ORPHA:3268)
These phenotypes are associated with the disease Radioulnar synostosis-microcephaly-scoliosis syndrome (ORPHA:3268).